Phenotypes associated with the disease Autosomal recessive omodysplasia (ORPHA:93329):
- Long philtrum (HP:0000343): Distance between nasal base and midline upper lip vermilion border more than 2 SD above the mean. Alternatively, an apparently increased distance between nasal base and midline upper lip vermilion border. Evidence: TAS. Frequency: Very frequent (HP:0040281). (ORPHA:93329)
- Posteriorly rotated ears (HP:0000358): A type of abnormal location of the ears in which the position of the ears is characterized by posterior rotation (the superior part of the ears is rotated towards the back of the head, and the inferior part of the ears towards the front). Evidence: TAS. Frequency: Very frequent (HP:0040281). (ORPHA:93329)
- Low-set ears (HP:0000369): Upper insertion of the ear to the scalp below an imaginary horizontal line drawn between the inner canthi of the eye and extending posteriorly to the ear. Evidence: TAS. Frequency: Very frequent (HP:0040281). (ORPHA:93329)
- Anteverted nares (HP:0000463): Anteriorly-facing nostrils viewed with the head in the Frankfurt horizontal and the eyes of the observer level with the eyes of the subject. This gives the appearance of an upturned nose (upturned nasal tip). Evidence: TAS. Frequency: Very frequent (HP:0040281). (ORPHA:93329)
- Abnormal metaphysis morphology (HP:0000944): An abnormality of one or more metaphysis, i.e., of the somewhat wider portion of a long bone that is adjacent to the epiphyseal growth plate and grows during childhood. Evidence: TAS. Frequency: Very frequent (HP:0040281). (ORPHA:93329)
- Frontal bossing (HP:0002007): Bilateral bulging of the lateral frontal bone prominences with relative sparing of the midline. Evidence: TAS. Frequency: Very frequent (HP:0040281). (ORPHA:93329)
- Abnormal morphology of the radius (HP:0002818): An abnormality of the radius. Evidence: TAS. Frequency: Very frequent (HP:0040281). (ORPHA:93329)
- Elbow dislocation (HP:0003042): Dislocation of the distal humerus out of the elbow joint, where the radius, ulna, and humerus meet. Evidence: TAS. Frequency: Very frequent (HP:0040281). (ORPHA:93329)
- Short stature (HP:0004322): A height below that which is expected according to age and gender norms. Although there is no universally accepted definition of short stature, many refer to "short stature" as height more than 2 standard deviations below the mean for age and gender (or below the 3rd percentile for age and gender dependent norms). Evidence: TAS. Frequency: Very frequent (HP:0040281). (ORPHA:93329)
- Hypoplastic distal humeri (HP:0005025): Underdevelopment of the distal portion of the humerus. Evidence: TAS. Frequency: Very frequent (HP:0040281). (ORPHA:93329)
- Depressed nasal bridge (HP:0005280): Posterior positioning of the nasal root in relation to the overall facial profile for age. Evidence: TAS. Frequency: Very frequent (HP:0040281). (ORPHA:93329)
- Rhizomelia (HP:0008905): Disproportionate shortening of the proximal segment of limbs (i.e. the femur and humerus). Evidence: TAS. Frequency: Very frequent (HP:0040281). (ORPHA:93329)
- Cryptorchidism (HP:0000028): Testis in inguinal canal. That is, absence of one or both testes from the scrotum owing to failure of the testis or testes to descend through the inguinal canal to the scrotum. Evidence: TAS. Frequency: Frequent (HP:0040282). (ORPHA:93329)
- Micrognathia (HP:0000347): Developmental hypoplasia of the mandible. Evidence: TAS. Frequency: Frequent (HP:0040282). (ORPHA:93329)
- Abnormal femur morphology (HP:0002823): Any anomaly of the structure of the femur. Evidence: TAS. Frequency: Frequent (HP:0040282). (ORPHA:93329)
- Micromelia (HP:0002983): The presence of abnormally small extremities. Evidence: TAS. Frequency: Frequent (HP:0040282). (ORPHA:93329)
- Mesomelia (HP:0003027): Shortening of the middle parts of the limbs (forearm and lower leg) in relation to the upper and terminal segments. Evidence: TAS. Frequency: Frequent (HP:0040282). (ORPHA:93329)
- Pterygium (HP:0001059): Pterygia are 'winglike' triangular membranes occurring in the neck, eyes, knees, elbows, ankles or digits. Evidence: TAS. Frequency: Occasional (HP:0040283). (ORPHA:93329)
- Intellectual disability (HP:0001249): The term intellectual disability or intellectual developmental disorder is used to describe significantly sub-average intellectual and adaptive functioning based on clinical assessment and as measured by individually administered, appropriately normed, standardized and validated tests of intellectual functioning and adaptive behavior, with onset during the developmental period from infancy through adolescence. Evidence: TAS. Frequency: Occasional (HP:0040283). (ORPHA:93329)
- Craniosynostosis (HP:0001363): Craniosynostosis refers to the premature closure of the cranial sutures. Primary craniosynostosis refers to the closure of one or more sutures due to abnormalities in skull development, and secondary craniosynostosis results from failure of brain growth. Evidence: TAS. Frequency: Occasional (HP:0040283). (ORPHA:93329)
- Short nose (HP:0003196): Distance from nasion to subnasale more than two standard deviations below the mean, or alternatively, an apparently decreased length from the nasal root to the nasal tip. Evidence: TAS. Frequency: Occasional (HP:0040283). (ORPHA:93329)
- Increased nuchal translucency (HP:0010880): Nuchal translucency is the sonographic appearance of subcutaneous accumulation of liquid in the back of the fetal neck in the first trimester of pregnancy (11-14 gestational weeks of pregnancy). Evidence: TAS. Frequency: Occasional (HP:0040283). (ORPHA:93329)
- Abnormal cardiovascular system morphology (HP:0030680): Any structural anomaly of the heart and blood vessels. Evidence: TAS. Frequency: Occasional (HP:0040283). (ORPHA:93329)
- Hernia (HP:0100790). Evidence: TAS. Frequency: Occasional (HP:0040283). (ORPHA:93329)